- Sensorineural hearing impairment (HP:0000407): A type of hearing impairment in one or both ears related to an abnormal functionality of the cochlear nerve. Evidence: TAS. (OMIM:603010)
- Autosomal recessive inheritance (HP:0000007): A mode of inheritance that is observed for traits related to a gene encoded on one of the autosomes (i.e., the human chromosomes 1-22) in which a trait manifests in individuals with two pathogenic alleles, either homozygotes (two copies of the same mutant allele) or compound heterozygotes (whereby each copy of a gene has a distinct mutant allele). Evidence: TAS. (OMIM:603010)
These phenotypes are associated with the disease autosomal recessive nonsyndromic hearing loss 17 (OMIM:603010).